Phenotypes associated with the disease dyschromatosis, ichthyosis, deafness, and atopic disease (OMIM:621400):
- Chronic rhinitis (HP:0002257): Chronic inflammation of the nasal mucosa. Evidence: PCS. Frequency: 2/2. (PMID:38701954)
- Juvenile onset (HP:0003621): Onset of signs or symptoms of disease between the age of 5 and 15 years. Evidence: PCS. Frequency: 2/2. (PMID:38701954)
- Hypopigmented macule (HP:0020073): A white or lighter patch of skin that may appear anywhere on the body and are caused by decreased skin pigmentation. Evidence: PCS. Frequency: 1/1. (PMID:38701954)
- Atopic dermatitis (HP:0001047): Atopic dermatitis (AD) or atopic eczema is an itchy, inflammatory skin condition with a predilection for the skin flexures. It is characterized by poorly defined erythema with edema, vesicles, and weeping in the acute stage and skin thickening (lichenification) in the chronic stage. Evidence: PCS. Frequency: 1/2. (PMID:38701954)
- Asthma (HP:0002099): Asthma is characterized by increased responsiveness of the tracheobronchial tree to multiple stimuli, leading to narrowing of the air passages with resultant dyspnea, cough, and wheezing. Evidence: PCS. Frequency: 2/2. (PMID:38701954)
- Facial telangiectasia (HP:0007380): Telangiectases (small dilated blood vessels) located near the surface of the skin of the face. Evidence: PCS. Frequency: 2/2. (PMID:38701954)
- Ichthyosis (HP:0008064): An abnormality of the skin characterized the presence of excessive amounts of dry surface scales on the skin resulting from an abnormality of keratinization. Evidence: PCS. Frequency: 2/2. (PMID:38701954)
- Hyperthyroidism (HP:0000836): An abnormality of thyroid physiology characterized by excessive secretion of the thyroid hormones thyroxine (i.e., T4) and/or 3,3',5-triiodo-L-thyronine zwitterion (i.e., triiodothyronine or T3). Evidence: PCS. Frequency: 1/2. (PMID:38701954)
- Sensorineural hearing impairment (HP:0000407): A type of hearing impairment in one or both ears related to an abnormal functionality of the cochlear nerve. Evidence: PCS. Frequency: 2/2. (PMID:38701954)
- Generalized hyperpigmentation (HP:0007440). Evidence: PCS. Frequency: 1/1. (PMID:38701954)
- Eczematoid dermatitis (HP:0000964): Eczema is a form of dermatitis that is characterized by scaly, pruritic, erythematous lesions located on flexural surfaces. Evidence: PCS. Frequency: 1/1. (PMID:38701954)
- Autosomal recessive inheritance (HP:0000007): A mode of inheritance that is observed for traits related to a gene encoded on one of the autosomes (i.e., the human chromosomes 1-22) in which a trait manifests in individuals with two pathogenic alleles, either homozygotes (two copies of the same mutant allele) or compound heterozygotes (whereby each copy of a gene has a distinct mutant allele). Evidence: PCS. (PMID:38701954)
- Hyperkeratosis (HP:0000962): Hyperkeratosis is a histopathological term defining a thickened stratum corneum and may be present in many different skin conditions, with many possible overlaps. Hyperkeratosis refers to the increased thickness of the stratum corneum, the outer layer of the skin. Hyperkeratosis is subclassified as orthokeratotic or parakeratotic. Orthokeratotic hyperkeratosis refers to the thickening of the keratin layer with preserved keratinocyte maturation, while parakeratotic hyperkeratosis shows retained nuclei as a sign of delayed maturation of keratinocytes. Evidence: PCS. Frequency: 1/1. (PMID:38701954)